Phenotypes associated with the disease mitochondrial complex IV deficiency, nuclear type 10 (OMIM:619053):
- Oligohydramnios (HP:0001562): Diminished amniotic fluid volume in pregnancy. Evidence: PCS. Frequency: 1/1. (PMID:22243966)
- Renal hypoplasia (HP:0000089): Hypoplasia of the kidney. Evidence: PCS. Frequency: 1/1. (PMID:22243966)
- Increased circulating lactate concentration (HP:0002151): Abnormally increased level of blood lactate (2-hydroxypropanoic acid). Lactate is produced from pyruvate by lactate dehydrogenase during normal metabolism. The terms lactate and lactic acid are often used interchangeably but lactate (the component measured in blood) is strictly a weak base whereas lactic acid is the corresponding acid. Lactic acidosis is often used clinically to describe elevated lactate but should be reserved for cases where there is a corresponding acidosis (pH below 7.35). Evidence: PCS. Frequency: 1/1. (PMID:22243966)
- Hepatomegaly (HP:0002240): Abnormally increased size of the liver. Evidence: PCS. Frequency: 1/1. (PMID:22243966)
- Increased CSF lactate (HP:0002490): Increased concentration of lactate in the cerebrospinal fluid. Evidence: PCS. Frequency: 1/1. (PMID:22243966)
- Abnormal CNS myelination (HP:0011400): An abnormality of myelination of nerves in the central nervous system. Evidence: PCS. Frequency: 1/1. (PMID:22243966)
- Ketonuria (HP:0002919): High levels of ketone bodies (acetoacetic acid, beta-hydroxybutyric acid, and acetone) in the urine. Ketone bodies are insignificant in the blood and urine of normal individuals in the postprandial or overnight-fasted state. Evidence: PCS. Frequency: 1/1. (PMID:22243966)
- Hypertrophic cardiomyopathy (HP:0001639): Hypertrophic cardiomyopathy (HCM) is defined by the presence of increased ventricular wall thickness or mass in the absence of loading conditions (hypertension, valve disease) sufficient to cause the observed abnormality. Evidence: PCS. Frequency: 1/1. (PMID:22243966)
- Single transverse palmar crease (HP:0000954): The distal and proximal transverse palmar creases are merged into a single transverse palmar crease. Evidence: PCS. Frequency: 1/1. (PMID:22243966)
- Autosomal recessive inheritance (HP:0000007): A mode of inheritance that is observed for traits related to a gene encoded on one of the autosomes (i.e., the human chromosomes 1-22) in which a trait manifests in individuals with two pathogenic alleles, either homozygotes (two copies of the same mutant allele) or compound heterozygotes (whereby each copy of a gene has a distinct mutant allele). Evidence: PCS. (PMID:22243966)
- Microphthalmia (HP:0000568): A developmental anomaly characterized by abnormal smallness of one or both eyes. Evidence: PCS. Frequency: 1/1. (PMID:22243966)
- Hypotelorism (HP:0000601): Interpupillary distance less than 2 SD below the mean (alternatively, the appearance of an decreased interpupillary distance or closely spaced eyes). Evidence: PCS. Frequency: 1/1. (PMID:22243966)
- High palate (HP:0000218): Height of the palate more than 2 SD above the mean (objective) or palatal height at the level of the first permanent molar more than twice the height of the teeth (subjective). Evidence: PCS. Frequency: 1/1. (PMID:22243966)
- Neonatal respiratory distress (HP:0002643): Respiratory difficulty as newborn. Evidence: PCS. Frequency: 1/1. (PMID:22243966)
- Metabolic acidosis (HP:0001942): Metabolic acidosis (MA) is characterized by a fall in blood pH due to a reduction of serum bicarbonate concentration. This can occur as a result of either the accumulation of acids (high anion gap MA) or the loss of bicarbonate from the gastrointestinal tract or the kidney (hyperchloremic MA). By definition, MA is not due to a respirary cause. Evidence: PCS. Frequency: 1/1. (PMID:22243966)